Phenotypes associated with the disease mitochondrial complex IV deficiency, nuclear type 4 (OMIM:619048):
- Axial hypotonia (HP:0008936): Muscular hypotonia (abnormally low muscle tone) affecting the musculature of the trunk. Evidence: PCS. Frequency: 1/1. (PMID:11013136)
- Hepatic steatosis (HP:0001397): Steatosis is a term used to denote lipid accumulation within hepatocytes. Evidence: PCS. Frequency: 1/1. (PMID:11013136)
- Elevated circulating aspartate aminotransferase concentration (HP:0031956): The concentration of aspartate aminotransferase (AST) in the blood circulation is above the upper limit of normal. Evidence: PCS. Frequency: 1/1. (PMID:19295170)
- Bradycardia (HP:0001662): A slower than normal heart rate (in adults, slower than 60 beats per minute). Evidence: PCS. Frequency: 1/1. (PMID:11013136)
- Increased circulating lactate concentration (HP:0002151): Abnormally increased level of blood lactate (2-hydroxypropanoic acid). Lactate is produced from pyruvate by lactate dehydrogenase during normal metabolism. The terms lactate and lactic acid are often used interchangeably but lactate (the component measured in blood) is strictly a weak base whereas lactic acid is the corresponding acid. Lactic acidosis is often used clinically to describe elevated lactate but should be reserved for cases where there is a corresponding acidosis (pH below 7.35). Evidence: PCS. Frequency: 2/2. (PMID:19295170;PMID:11013136)
- Hepatomegaly (HP:0002240): Abnormally increased size of the liver. Evidence: PCS. Frequency: 1/1. (PMID:19295170)
- Generalized hypotonia (HP:0001290): Generalized muscular hypotonia (abnormally low muscle tone). Evidence: PCS. Frequency: 1/1. (PMID:19295170)
- Brain atrophy (HP:0012444): Partial or complete wasting (loss) of brain tissue that was once present. Evidence: PCS. Frequency: 1/1. (PMID:19295170)
- Elevated circulating alanine aminotransferase concentration (HP:0031964): An abnormally high concentration in the circulation of alanine aminotransferase (ALT). Evidence: PCS. Frequency: 1/1. (PMID:19295170)
- Failure to thrive (HP:0001508): Failure to thrive (FTT) refers to a child whose physical growth is substantially below the norm. Evidence: PCS. Frequency: 1/1. (PMID:19295170)
- Autosomal recessive inheritance (HP:0000007): A mode of inheritance that is observed for traits related to a gene encoded on one of the autosomes (i.e., the human chromosomes 1-22) in which a trait manifests in individuals with two pathogenic alleles, either homozygotes (two copies of the same mutant allele) or compound heterozygotes (whereby each copy of a gene has a distinct mutant allele). Evidence: PCS. (PMID:11013136)
- Hypoglycemia (HP:0001943): A decreased concentration of glucose in the blood. Evidence: PCS. Frequency: 1/1. (PMID:11013136)
- Left ventricular hypertrophy (HP:0001712): Enlargement or increased size of the heart left ventricle. Evidence: PCS. Frequency: 1/1. (PMID:19295170)
- Feeding difficulties in infancy (HP:0008872): Impaired feeding performance of an infant as manifested by difficulties such as weak and ineffective sucking, brief bursts of sucking, and falling asleep during sucking. There may be difficulties with chewing or maintaining attention. Evidence: PCS. Frequency: 1/1. (PMID:19295170)
- Congestive heart failure (HP:0001635): The presence of an abnormality of cardiac function that is responsible for the failure of the heart to pump blood at a rate that is commensurate with the needs of the tissues or a state in which abnormally elevated filling pressures are required for the heart to do so. Heart failure is frequently related to a defect in myocardial contraction. Evidence: PCS. Frequency: 1/1. (PMID:19295170)
- Ventricular hypertrophy (HP:0001714): Enlargement of the cardiac ventricular muscle tissue with increase in the width of the wall of the ventricle and loss of elasticity. Ventricular hypertrophy is clinically differentiated into left and right ventricular hypertrophy. Evidence: PCS. Frequency: 1/1. (PMID:19295170)
- Intrauterine growth retardation (HP:0001511): An abnormal restriction of fetal growth with fetal weight below the tenth percentile for gestational age. Evidence: PCS. Frequency: 1/1. (PMID:19295170)
- Decreased plasma free carnitine (HP:0008315): A decreased concentration of free (unbound) carnitine in the blood. Evidence: PCS. Frequency: 1/1. (PMID:19295170)
- Increased urine succinate level (HP:0033092): The concentration of succinate in the urine, normalized for urine concentration, is above the upper limit of normal. Evidence: PCS. Frequency: 1/1. (PMID:11013136)
- Apnea (HP:0002104): Lack of breathing with no movement of the respiratory muscles and no exchange of air in the lungs. This term refers to a disposition to have recurrent episodes of apnea rather than to a single event. Evidence: PCS. Frequency: 1/1. (PMID:11013136)
- Metabolic acidosis (HP:0001942): Metabolic acidosis (MA) is characterized by a fall in blood pH due to a reduction of serum bicarbonate concentration. This can occur as a result of either the accumulation of acids (high anion gap MA) or the loss of bicarbonate from the gastrointestinal tract or the kidney (hyperchloremic MA). By definition, MA is not due to a respirary cause. Evidence: PCS. Frequency: 1/1. (PMID:11013136)
- Hyperalaninemia (HP:0003348): An increased concentration of alanine in the blood. Evidence: PCS. Frequency: 1/1. (PMID:19295170)